Phenotypes associated with the disease cerebellar ataxia, intellectual disability, and dysequilibrium syndrome 1 (OMIM:224050):
- Poor speech (HP:0002465). Evidence: IEA. (OMIM:224050)
- Congenital onset (HP:0003577): A phenotypic abnormality that is present at birth. Evidence: TAS. (OMIM:224050)
- Strabismus (HP:0000486): A misalignment of the eyes so that the visual axes deviate from bifoveal fixation. The classification of strabismus may be based on a number of features including the relative position of the eyes, whether the deviation is latent or manifest, intermittent or constant, concomitant or otherwise and according to the age of onset and the relevance of any associated refractive error. Evidence: PCS. Frequency: 4/4. (PMID:18326629)
- Gaze-evoked nystagmus (HP:0000640): Nystagmus made apparent by looking to the right or to the left. Evidence: IEA. (OMIM:224050)
- Short stature (HP:0004322): A height below that which is expected according to age and gender norms. Although there is no universally accepted definition of short stature, many refer to "short stature" as height more than 2 standard deviations below the mean for age and gender (or below the 3rd percentile for age and gender dependent norms). Evidence: IEA. (OMIM:224050)
- Hypoplasia of the brainstem (HP:0002365): Underdevelopment of the brainstem. Evidence: TAS. (OMIM:224050)
- Dysmetria (HP:0001310): A type of ataxia characterized by the inability to carry out movements with the correct range and motion across the plane of more than one joint related to incorrect estimation of the distances required for targeted movements. Evidence: TAS. (OMIM:224050)
- Seizure (HP:0001250): A seizure is an intermittent abnormality of nervous system physiology characterized by a transient occurrence of signs and/or symptoms due to abnormal excessive or synchronous neuronal activity in the brain. Evidence: PCS. Frequency: 2/4. (PMID:18326629)
- Cerebellar atrophy (HP:0001272): Cerebellar atrophy is defined as a cerebellum with initially normal structures, in a posterior fossa with normal size, which displays enlarged fissures (interfolial spaces) in comparison to the foliae secondary to loss of tissue. Cerebellar atrophy implies irreversible loss of tissue and result from an ongoing progressive disease until a final stage is reached or a single injury, e.g. an intoxication or infectious event. Evidence: IEA. (OMIM:224050)
- Gait ataxia (HP:0002066): A type of ataxia characterized by the impairment of the ability to coordinate the movements required for normal walking. Gait ataxia is characteirzed by a wide-based staggering gait with a tendency to fall. Evidence: IEA. (OMIM:224050)
- Hypotonia (HP:0001252): Hypotonia is an abnormally low muscle tone (the amount of tension or resistance to movement in a muscle). Even when relaxed, muscles have a continuous and passive partial contraction which provides some resistance to passive stretching. Hypotonia thus manifests as diminished resistance to passive stretching. Hypotonia is not the same as muscle weakness, although the two conditions can co-exist. Evidence: IEA. (OMIM:224050)
- Infantile onset (HP:0003593): Onset of signs or symptoms of disease between 28 days to one year of life. Evidence: PCS. Frequency: 4/4. (PMID:18326629)
- Generalized hypotonia (HP:0001290): Generalized muscular hypotonia (abnormally low muscle tone). Evidence: TAS. (OMIM:224050)
- Intention tremor (HP:0002080): A type of kinetic tremor that occurs during target directed movement is called intention tremor. That is, an oscillatory cerebellar ataxia that tends to be absent when the limbs are inactive and during the first part of voluntary movement but worsening as the movement continues and greater precision is required (e.g., in touching a target such as the patient's nose or a physician's finger). Evidence: IEA. (OMIM:224050)
- Cataract (HP:0000518): A cataract is an opacity or clouding that develops in the crystalline lens of the eye or in its capsule. Evidence: IEA. (OMIM:224050)
- Inferior cerebellar vermis hypoplasia (HP:0007068): Underdevelopment of the inferior portion of the vermis of cerebellum. Evidence: PCS. Frequency: 4/4. (PMID:18326629)
- Pachygyria (HP:0001302): Pachygyria is a malformation of cortical development with abnormally wide gyri with sulci 1,5-3 cm apart and abnormally thick cortex measuring more than 5 mm (radiological definition). See also neuropathological definitions for 2-, 3-, and 4-layered lissencephaly. Evidence: TAS. (OMIM:224050)
- Pes planus (HP:0001763): A foot where the longitudinal arch of the foot is in contact with the ground or floor when the individual is standing; or, in a patient lying supine, a foot where the arch is in contact with the surface of a flat board pressed against the sole of the foot by the examiner with a pressure similar to that expected from weight bearing; or, the height of the arch is reduced. Evidence: PCS. Frequency: 4/4. (PMID:18326629)
- Intellectual disability (HP:0001249): The term intellectual disability or intellectual developmental disorder is used to describe significantly sub-average intellectual and adaptive functioning based on clinical assessment and as measured by individually administered, appropriately normed, standardized and validated tests of intellectual functioning and adaptive behavior, with onset during the developmental period from infancy through adolescence. Evidence: PCS. Frequency: 4/4. (PMID:18326629)
- Hyperreflexia (HP:0001347): Hyperreflexia is the presence of hyperactive stretch reflexes of the muscles. Evidence: IEA. (OMIM:224050)
- Broad-based gait (HP:0002136): An abnormal gait pattern in which persons stand and walk with their feet spaced widely apart. This is often a component of cerebellar ataxia. Evidence: IEA. (OMIM:224050)
- Truncal ataxia (HP:0002078): Truncal ataxia is a sign of ataxia characterized by instability of the trunk. It usually occurs during sitting. Evidence: PCS. Frequency: 4/4. (PMID:18326629)
- Delayed speech and language development (HP:0000750): A degree of language development that is significantly below the norm for a child of a specified age. Evidence: TAS. (OMIM:224050)
- Cerebellar hypoplasia (HP:0001321): Cerebellar hypoplasia is a descriptive term implying a cerebellum with a reduced volume, but a normal shape and is stable over time. Evidence: PCS. Frequency: 4/4. (PMID:18326629)
- Delayed ability to walk (HP:0031936): A failure to achieve the ability to walk at an appropriate developmental stage. Most children learn to walk in a series of stages, and learn to walk short distances independently between 12 and 15 months. Evidence: PCS. Frequency: 4/4. (PMID:18326629)
- Lower limb hyperreflexia (HP:0002395): Increased intensity of the a reflex in the leg. Evidence: PCS. Frequency: 4/4. (PMID:18326629)
- Dysarthria (HP:0001260): Dysarthric speech is a general description referring to a neurological speech disorder characterized by poor articulation. Depending on the involved neurological structures, dysarthria may be further classified as spastic, flaccid, ataxic, hyperkinetic and hypokinetic, or mixed. Evidence: PCS. Frequency: 4/4. (PMID:18326629)
- Nonprogressive (HP:0003680): Applies to a disease manifestation that does not increase in scope or severity over the course of time, i.e., that does not worsen with age. Evidence: IEA. (OMIM:224050)
- Global developmental delay (HP:0001263): A delay in the achievement of motor or mental milestones in the domains of development of a child, including motor skills, speech and language, cognitive skills, and social and emotional skills. This term should only be used to describe children younger than five years of age. Evidence: PCS. Frequency: 4/4. (PMID:18326629)
- Dysdiadochokinesis (HP:0002075): A type of ataxia characterized by the impairment of the ability to perform rapidly alternating movements, such as pronating and supinating his or her hand on the dorsum of the other hand as rapidly as possible. Evidence: TAS. (OMIM:224050)
- Autosomal recessive inheritance (HP:0000007): A mode of inheritance that is observed for traits related to a gene encoded on one of the autosomes (i.e., the human chromosomes 1-22) in which a trait manifests in individuals with two pathogenic alleles, either homozygotes (two copies of the same mutant allele) or compound heterozygotes (whereby each copy of a gene has a distinct mutant allele). Evidence: PCS. (PMID:16080122)
- Cerebellar ataxia associated with quadrupedal gait (HP:0009878): The presence of cerebellar signs and symptoms such as lack of balance associated with quadrupedal gait (locomotion on all four extremities with a 'bear-like' gait with the legs held straight). Evidence: PCS. Frequency: 4/4. (PMID:18326629)
- Simplified gyral pattern (HP:0009879): An abnormality of the cerebral cortex with fewer gyri but with normal cortical thickness. This pattern is usually often associated with congenital microcephaly. Evidence: IEA. (OMIM:224050)